- Cryptorchidism (HP:0000028): Testis in inguinal canal. That is, absence of one or both testes from the scrotum owing to failure of the testis or testes to descend through the inguinal canal to the scrotum. Evidence: TAS. Frequency: Frequent (HP:0040282). (ORPHA:221120)
- High palate (HP:0000218): Height of the palate more than 2 SD above the mean (objective) or palatal height at the level of the first permanent molar more than twice the height of the teeth (subjective). Evidence: TAS. Frequency: Frequent (HP:0040282). (ORPHA:221120)
- Hypertelorism (HP:0000316): Interpupillary distance more than 2 SD above the mean (alternatively, the appearance of an increased interpupillary distance or widely spaced eyes). Evidence: TAS. Frequency: Frequent (HP:0040282). (ORPHA:221120)
- Clinodactyly of the 4th finger (HP:0040025). Evidence: TAS. Frequency: Occasional (HP:0040283). (ORPHA:221120)
- Postaxial polydactyly (HP:0100259): A form of polydactyly in which the extra digit or digits are localized on the side of the fifth finger or fifth toe. Evidence: TAS. Frequency: Occasional (HP:0040283). (ORPHA:221120)
- Clubbing of fingers (HP:0100759): Terminal broadening of the fingers (distal phalanges of the fingers). Evidence: TAS. Frequency: Occasional (HP:0040283). (ORPHA:221120)
- Micrognathia (HP:0000347): Developmental hypoplasia of the mandible. Evidence: TAS. Frequency: Frequent (HP:0040282). (ORPHA:221120)
- Posteriorly rotated ears (HP:0000358): A type of abnormal location of the ears in which the position of the ears is characterized by posterior rotation (the superior part of the ears is rotated towards the back of the head, and the inferior part of the ears towards the front). Evidence: TAS. Frequency: Frequent (HP:0040282). (ORPHA:221120)
- Prominent nasal bridge (HP:0000426): Anterior positioning of the nasal root in comparison to the usual positioning for age. Evidence: TAS. Frequency: Frequent (HP:0040282). (ORPHA:221120)
- Proptosis (HP:0000520): An eye that is protruding anterior to the plane of the face to a greater extent than is typical. Evidence: TAS. Frequency: Frequent (HP:0040282). (ORPHA:221120)
- Blepharophimosis (HP:0000581): A fixed reduction in the vertical distance between the upper and lower eyelids with short palpebral fissures. Evidence: TAS. Frequency: Frequent (HP:0040282). (ORPHA:221120)
- Intellectual disability (HP:0001249): The term intellectual disability or intellectual developmental disorder is used to describe significantly sub-average intellectual and adaptive functioning based on clinical assessment and as measured by individually administered, appropriately normed, standardized and validated tests of intellectual functioning and adaptive behavior, with onset during the developmental period from infancy through adolescence. Evidence: TAS. Frequency: Frequent (HP:0040282). (ORPHA:221120)
- Frontal upsweep of hair (HP:0002236): Upward and/or sideward growth of anterior hair. Evidence: TAS. Frequency: Frequent (HP:0040282). (ORPHA:221120)
- Highly arched eyebrow (HP:0002553): Increased height of the central portion of the eyebrow, forming a crescent, semicircular, or inverted U shape. Evidence: TAS. Frequency: Frequent (HP:0040282). (ORPHA:221120)
- Limited elbow movement (HP:0002996). Evidence: TAS. Frequency: Frequent (HP:0040282). (ORPHA:221120)
- Short stature (HP:0004322): A height below that which is expected according to age and gender norms. Although there is no universally accepted definition of short stature, many refer to "short stature" as height more than 2 standard deviations below the mean for age and gender (or below the 3rd percentile for age and gender dependent norms). Evidence: TAS. Frequency: Frequent (HP:0040282). (ORPHA:221120)
- Underdeveloped supraorbital ridges (HP:0009891): Flatness of the supraorbital portion of the frontal bones. Evidence: TAS. Frequency: Frequent (HP:0040282). (ORPHA:221120)
- Abnormal temporal bone morphology (HP:0009911): Abnormality of the temporal bone of the skull, which is situated at the sides and base of the skull roughly underlying the region of the face known as the temple. Evidence: TAS. Frequency: Frequent (HP:0040282). (ORPHA:221120)
- Patchy reduction of bone mineral density (HP:0010657): Patchy (irregular) reduction in bone density. This can take on many forms depending on severity and distribution as can be seen on x-rays. Evidence: TAS. Frequency: Frequent (HP:0040282). (ORPHA:221120)
- Abnormality of limbs (HP:0040064). Evidence: TAS. Frequency: Frequent (HP:0040282). (ORPHA:221120)
- Inguinal hernia (HP:0000023): Protrusion of the contents of the abdominal cavity through the inguinal canal. Evidence: TAS. Frequency: Occasional (HP:0040283). (ORPHA:221120)
- Horseshoe kidney (HP:0000085): A connection of the right and left kidney by an isthmus of functioning renal parenchyma or fibrous tissue that crosses the midline. Evidence: TAS. Frequency: Occasional (HP:0040283). (ORPHA:221120)
- Orofacial cleft (HP:0000202): The presence of a cleft (gap, opening, or groove) in the oral cavity, including cleft of the upper lip and/or cleft of the palate. Cleft of the upper lip is visible as a groove or fissure in the lip, most frequently due to a congenital failure of the maxillary and median nasal processes to fuse. Cleft palate is characterized by a grooved depression or fissure in the roof of the mouth, most often resulting from a congenital failure of the palate to fuse properly. Clefts of the lip and palate can occur individually or together. It is preferable to code each defect separately. Evidence: TAS. Frequency: Occasional (HP:0040283). (ORPHA:221120)
- Hydrocephalus (HP:0000238): Hydrocephalus is an active distension of the ventricular system of the brain resulting from inadequate passage of CSF from its point of production within the cerebral ventricles to its point of absorption into the systemic circulation. Evidence: TAS. Frequency: Occasional (HP:0040283). (ORPHA:221120)
- Macrocephaly (HP:0000256): Occipitofrontal (head) circumference greater than 97th centile compared to appropriate, age matched, sex-matched normal standards. Alternatively, a apparently increased size of the cranium. Evidence: TAS. Frequency: Occasional (HP:0040283). (ORPHA:221120)
- Dolichocephaly (HP:0000268): An abnormality of skull shape characterized by a increased anterior-posterior diameter, i.e., an increased antero-posterior dimension of the skull. Cephalic index less than 76%. Alternatively, an apparently increased antero-posterior length of the head compared to width. Often due to premature closure of the sagittal suture. Evidence: TAS. Frequency: Occasional (HP:0040283). (ORPHA:221120)
- Epicanthus (HP:0000286): A fold of skin starting above the medial aspect of the upper eyelid and arching downward to cover, pass in front of and lateral to the medial canthus. Evidence: TAS. Frequency: Occasional (HP:0040283). (ORPHA:221120)
- Short philtrum (HP:0000322): Distance between nasal base and midline upper lip vermilion border more than 2 SD below the mean. Alternatively, an apparently decreased distance between nasal base and midline upper lip vermilion border. Evidence: TAS. Frequency: Occasional (HP:0040283). (ORPHA:221120)
- Facial asymmetry (HP:0000324): An abnormal difference between the left and right sides of the face. Evidence: TAS. Frequency: Occasional (HP:0040283). (ORPHA:221120)
- Broad forehead (HP:0000337): Width of the forehead or distance between the frontotemporales is more than two standard deviations above the mean (objective); or apparently increased distance between the two sides of the forehead. Evidence: TAS. Frequency: Occasional (HP:0040283). (ORPHA:221120)
- Absent earlobe (HP:0000387): Absence of fleshy non-cartilaginous tissue inferior to the tragus and incisura. Evidence: TAS. Frequency: Occasional (HP:0040283). (ORPHA:221120)
- Ophthalmoplegia (HP:0000602): Paralysis of one or more extraocular muscles that are responsible for eye movements. Evidence: TAS. Frequency: Occasional (HP:0040283). (ORPHA:221120)
- Microdontia (HP:0000691): Decreased size of the teeth, which can be defined as a mesiodistal tooth diameter (width) more than 2 SD below mean. Alternatively, an apparently decreased maximum width of tooth. Evidence: TAS. Frequency: Occasional (HP:0040283). (ORPHA:221120)
- Pectus excavatum (HP:0000767): A defect of the chest wall characterized by a depression of the sternum, giving the chest ("pectus") a caved-in ("excavatum") appearance. Evidence: TAS. Frequency: Occasional (HP:0040283). (ORPHA:221120)
- Prominent sternum (HP:0000884). Evidence: TAS. Frequency: Occasional (HP:0040283). (ORPHA:221120)
- Single transverse palmar crease (HP:0000954): The distal and proximal transverse palmar creases are merged into a single transverse palmar crease. Evidence: TAS. Frequency: Occasional (HP:0040283). (ORPHA:221120)
- Brachydactyly (HP:0001156): Digits that appear disproportionately short compared to the hand/foot. The word brachydactyly is used here to describe a series distinct patterns of shortened digits (brachydactyly types A-E). This is the sense used here. Evidence: TAS. Frequency: Occasional (HP:0040283). (ORPHA:221120)
- Slender finger (HP:0001238): Fingers that are disproportionately narrow (reduced girth) for the hand/foot size or build of the individual. Evidence: TAS. Frequency: Occasional (HP:0040283). (ORPHA:221120)
- Global developmental delay (HP:0001263): A delay in the achievement of motor or mental milestones in the domains of development of a child, including motor skills, speech and language, cognitive skills, and social and emotional skills. This term should only be used to describe children younger than five years of age. Evidence: TAS. Frequency: Occasional (HP:0040283). (ORPHA:221120)
- Hypernasal speech (HP:0001611): A type of speech characterized by the presence of an abnormally increased nasal airflow during speech associated with structural abnormality of the nasal passages. Evidence: TAS. Frequency: Occasional (HP:0040283). (ORPHA:221120)
- Patent foramen ovale (HP:0001655): Failure of the foramen ovale to seal postnatally, leaving a potential conduit between the left and right cardiac atria. Evidence: TAS. Frequency: Occasional (HP:0040283). (ORPHA:221120)
- Asplenia (HP:0001746): Absence (aplasia) of the spleen. Evidence: TAS. Frequency: Occasional (HP:0040283). (ORPHA:221120)
- Pes planus (HP:0001763): A foot where the longitudinal arch of the foot is in contact with the ground or floor when the individual is standing; or, in a patient lying supine, a foot where the arch is in contact with the surface of a flat board pressed against the sole of the foot by the examiner with a pressure similar to that expected from weight bearing; or, the height of the arch is reduced. Evidence: TAS. Frequency: Occasional (HP:0040283). (ORPHA:221120)
- Overlapping toe (HP:0001845): Describes a foot digit resting on the dorsal surface of an adjacent digit when the foot is at rest. Initially clawing may be dynamic and only noticeable on walking. Over time the plantar plate tears, subluxation occurs at the metatarsophalangeal joint (MTPJ), and the deformity becomes permanent. Evidence: TAS. Frequency: Occasional (HP:0040283). (ORPHA:221120)
- Clinodactyly of the 5th toe (HP:0001864): Bending or curvature of a fifth toe in the tibial direction (i.e., towards the big toe). Evidence: TAS. Frequency: Occasional (HP:0040283). (ORPHA:221120)
- Frontal bossing (HP:0002007): Bilateral bulging of the lateral frontal bone prominences with relative sparing of the midline. Evidence: TAS. Frequency: Occasional (HP:0040283). (ORPHA:221120)
- Poor suck (HP:0002033): An inadequate sucking reflex, resulting in the difficult of newborns to be breast-fed. Evidence: TAS. Frequency: Occasional (HP:0040283). (ORPHA:221120)
- Sparse scalp hair (HP:0002209): Decreased number of hairs per unit area of skin of the scalp. Evidence: TAS. Frequency: Occasional (HP:0040283). (ORPHA:221120)
- Inverted nipples (HP:0003186): The presence of nipples that instead of pointing outward are retracted inwards. Evidence: TAS. Frequency: Occasional (HP:0040283). (ORPHA:221120)
- Fatigable weakness (HP:0003473): A type of weakness that occurs after a muscle group is used and lessens if the muscle group has some rest. That is, there is diminution of strength with repetitive muscle actions. Evidence: TAS. Frequency: Occasional (HP:0040283). (ORPHA:221120)
- Sagittal craniosynostosis (HP:0004442): A kind of craniosynostosis affecting the sagittal suture. Evidence: TAS. Frequency: Occasional (HP:0040283). (ORPHA:221120)
- Talipes valgus (HP:0004684): Outward turning of the heel, resulting in clubfoot with the person walking on the inner part of the foot. Evidence: TAS. Frequency: Occasional (HP:0040283). (ORPHA:221120)
- Synostosis of carpal bones (HP:0005048). Evidence: TAS. Frequency: Occasional (HP:0040283). (ORPHA:221120)
- Wide intermamillary distance (HP:0006610): A larger than usual distance between the left and right nipple. Evidence: TAS. Frequency: Occasional (HP:0040283). (ORPHA:221120)
- Mild conductive hearing impairment (HP:0008598): A mild form of conductive hearing impairment. Evidence: TAS. Frequency: Occasional (HP:0040283). (ORPHA:221120)
- Floppy infant (HP:0008947): Floppiness/hypotonia is defined as reduced resistance to passive movement of joints. Physical examination of floppy/hypotonic infants shows head lag, lack of shoulder and elbow muscle contraction on traction response, inability to tighten the shoulder girdle muscles (or slipping through) when held under the axillae, scarf sign (when the arm is pulled to the opposite side, the arm wraps around the neck with the elbow crossing midline), hyperdorsiflexion of the feet, easy apposition of the thumb against the forearm, feet touching the cheek with ease and without discomfort, frog leg position, and inverted U sign on ventral suspension (head, arms, and legs hanging down without elbow or knee flexion and the trunk rounded in a dome shape). Evidence: TAS. Frequency: Occasional (HP:0040283). (ORPHA:221120)
- Hypoplasia of the antihelix (HP:0009739): Developmental hypoplasia of the antihelix. Evidence: TAS. Frequency: Occasional (HP:0040283). (ORPHA:221120)
- Short thumb (HP:0009778): Hypoplasia (congenital reduction in size) of the thumb. Evidence: TAS. Frequency: Occasional (HP:0040283). (ORPHA:221120)
- Short 4th metacarpal (HP:0010044): Short fourth metacarpal bone. Evidence: TAS. Frequency: Occasional (HP:0040283). (ORPHA:221120)
- Sacrococcygeal pilonidal abnormality (HP:0010767): The presence of a cyst, fistula, or abscess in the sacrococcygeal region (gluteal crease) characteristically accompanied by hair and skin folds. Evidence: TAS. Frequency: Occasional (HP:0040283). (ORPHA:221120)
- Nasogastric tube feeding in infancy (HP:0011470): Feeding problem necessitating nasogastric tube feeding. Evidence: TAS. Frequency: Occasional (HP:0040283). (ORPHA:221120)
- Posterolateral diaphragmatic hernia (HP:0025193): A posterolateral defect in the diaphragm, commonly referred to as a Bochdalek hernia, which is often accompanied by herniation of the stomach, intestines, liver, and/or spleen into the chest cavity. Evidence: TAS. Frequency: Occasional (HP:0040283). (ORPHA:221120)
- Hip subluxation (HP:0030043): A partial dislocation of the hip joint, whereby the head of the femur is partially displaced from the socket. Evidence: TAS. Frequency: Occasional (HP:0040283). (ORPHA:221120)
These phenotypes are associated with the disease Pseudoaminopterin syndrome (ORPHA:221120).